Phenotypes associated with the disease microcephaly-cardiomyopathy syndrome (OMIM:251220):
- Microcephaly (HP:0000252): Head circumference below 2 standard deviations below the mean for age and gender. Evidence: IEA. (OMIM:251220)
- Autosomal recessive inheritance (HP:0000007): A mode of inheritance that is observed for traits related to a gene encoded on one of the autosomes (i.e., the human chromosomes 1-22) in which a trait manifests in individuals with two pathogenic alleles, either homozygotes (two copies of the same mutant allele) or compound heterozygotes (whereby each copy of a gene has a distinct mutant allele). Evidence: IEA. (OMIM:251220)
- Clinodactyly of the 5th finger (HP:0004209): Clinodactyly refers to a bending or curvature of the fifth finger in the radial direction (i.e., towards the 4th finger). Evidence: IEA. (OMIM:251220)
- Sandal gap (HP:0001852): A widely spaced gap between the first toe (the great toe) and the second toe. Evidence: IEA. (OMIM:251220)
- Intellectual disability (HP:0001249): The term intellectual disability or intellectual developmental disorder is used to describe significantly sub-average intellectual and adaptive functioning based on clinical assessment and as measured by individually administered, appropriately normed, standardized and validated tests of intellectual functioning and adaptive behavior, with onset during the developmental period from infancy through adolescence. Evidence: IEA. (OMIM:251220)
- Dilated cardiomyopathy (HP:0001644): Dilated cardiomyopathy (DCM) is defined by the presence of left ventricular dilatation and left ventricular systolic dysfunction in the absence of abnormal loading conditions (hypertension, valve disease) or coronary artery disease sufficient to cause global systolic impairment. Right ventricular dilation and dysfunction may be present but are not necessary for the diagnosis. Evidence: IEA. (OMIM:251220)